- Non-Mendelian inheritance (HP:0001426): A mode of inheritance that depends on genetic determinants in more than one gene. Evidence: IEA. (OMIM:142340)
- Congenital diaphragmatic hernia (HP:0000776): The presence of a hernia of the diaphragm present at birth. Evidence: IEA. (OMIM:142340)
These phenotypes are associated with the disease diaphragmatic hernia 1 (OMIM:142340).